- Lop ear (HP:0000394): Anterior and inferior folding of the upper portion of the ear that obliterates triangular fossa and scapha. Evidence: TAS. Frequency: Very frequent (HP:0040281). (ORPHA:140952)
- Toe syndactyly (HP:0001770): Webbing or fusion of the toes, involving soft parts only or including bone structure. Bony fusions are referred to as "bony" Syndactyly if the fusion occurs in a radio-ulnar axis. Fusions of bones of the toes in a proximo-distal axis are referred to as "Symphalangism". Evidence: TAS. Frequency: Very frequent (HP:0040281). (ORPHA:140952)
- Anal atresia (HP:0002023): Congenital absence of the anus, i.e., the opening at the bottom end of the intestinal tract. Evidence: TAS. Frequency: Very frequent (HP:0040281). (ORPHA:140952)
- Clinodactyly of the 5th finger (HP:0004209): Clinodactyly refers to a bending or curvature of the fifth finger in the radial direction (i.e., towards the 4th finger). Evidence: TAS. Frequency: Very frequent (HP:0040281). (ORPHA:140952)
- Short stature (HP:0004322): A height below that which is expected according to age and gender norms. Although there is no universally accepted definition of short stature, many refer to "short stature" as height more than 2 standard deviations below the mean for age and gender (or below the 3rd percentile for age and gender dependent norms). Evidence: TAS. Frequency: Very frequent (HP:0040281). (ORPHA:140952)
- Labial hypoplasia (HP:0000066). Evidence: TAS. Frequency: Frequent (HP:0040282). (ORPHA:140952)
- Vesicoureteral reflux (HP:0000076): Abnormal (retrograde) movement of urine from the bladder into ureters or kidneys related to inadequacy of the valvular mechanism at the ureterovesicular junction or other causes. Evidence: TAS. Frequency: Frequent (HP:0040282). (ORPHA:140952)
- Renal insufficiency (HP:0000083): A reduction in the level of performance of the kidneys in areas of function comprising the concentration of urine, removal of wastes, the maintenance of electrolyte balance, homeostasis of blood pressure, and calcium metabolism. Evidence: TAS. Frequency: Frequent (HP:0040282). (ORPHA:140952)
- Horseshoe kidney (HP:0000085): A connection of the right and left kidney by an isthmus of functioning renal parenchyma or fibrous tissue that crosses the midline. Evidence: TAS. Frequency: Frequent (HP:0040282). (ORPHA:140952)
- Ectopic kidney (HP:0000086): A developmental defect in which a kidney is located in an abnormal anatomic position. Evidence: TAS. Frequency: Frequent (HP:0040282). (ORPHA:140952)
- Renal agenesis (HP:0000104): Agenesis, that is, failure of the kidney to develop during embryogenesis and development. Evidence: TAS. Frequency: Frequent (HP:0040282). (ORPHA:140952)
- Thin upper lip vermilion (HP:0000219): Height of the vermilion of the upper lip in the midline more than 2 SD below the mean. Alternatively, an apparently reduced height of the vermilion of the upper lip in the frontal view (subjective). Evidence: TAS. Frequency: Frequent (HP:0040282). (ORPHA:140952)
- Bulbous nose (HP:0000414): Increased volume and globular shape of the anteroinferior aspect of the nose. Evidence: TAS. Frequency: Frequent (HP:0040282). (ORPHA:140952)
- Wide nasal bridge (HP:0000431): Increased breadth of the nasal bridge (and with it, the nasal root). Evidence: TAS. Frequency: Frequent (HP:0040282). (ORPHA:140952)
- Telecanthus (HP:0000506): Distance between the inner canthi more than two standard deviations above the mean (objective); or, apparently increased distance between the inner canthi. Evidence: TAS. Frequency: Frequent (HP:0040282). (ORPHA:140952)
- Bicornuate uterus (HP:0000813): The presence of a bicornuate uterus. Evidence: TAS. Frequency: Frequent (HP:0040282). (ORPHA:140952)
- Abnormal cardiac septum morphology (HP:0001671): An anomaly of the intra-atrial or intraventricular septum. Evidence: TAS. Frequency: Frequent (HP:0040282). (ORPHA:140952)
- Clitoral hypertrophy (HP:0008665): Hypertrophy of the clitoris. Evidence: TAS. Frequency: Frequent (HP:0040282). (ORPHA:140952)
- Myopia (HP:0000545): An abnormality of refraction characterized by the ability to see objects nearby clearly, while objects in the distance appear blurry. Evidence: TAS. Frequency: Occasional (HP:0040283). (ORPHA:140952)
- Retinal dystrophy (HP:0000556): Retinal dystrophy is an abnormality of the retina associated with a hereditary process. Retinal dystrophies are defined by their predominantly monogenic inheritance and they are frequently associated with loss or dysfunction of photoreceptor cells as a primary or secondary event. Evidence: TAS. Frequency: Occasional (HP:0040283). (ORPHA:140952)
- Eyelid coloboma (HP:0000625): A short discontinuity of the margin of the lower or upper eyelid. Evidence: TAS. Frequency: Occasional (HP:0040283). (ORPHA:140952)
- Seizure (HP:0001250): A seizure is an intermittent abnormality of nervous system physiology characterized by a transient occurrence of signs and/or symptoms due to abnormal excessive or synchronous neuronal activity in the brain. Evidence: TAS. Frequency: Occasional (HP:0040283). (ORPHA:140952)
- Aortic regurgitation (HP:0001659): An insufficiency of the aortic valve, leading to regurgitation (backward flow) of blood from the aorta into the left ventricle. Evidence: TAS. Frequency: Occasional (HP:0040283). (ORPHA:140952)
- Hypoplasia of the radius (HP:0002984): Underdevelopment of the radius. Evidence: TAS. Frequency: Occasional (HP:0040283). (ORPHA:140952)
- Syringomyelia (HP:0003396): Dilated, glial-lined cavity in spinal cord. This cavity does not communicate with the central canal, and usually is between the dorsal columns unilaterally or bilaterally along the side of the cord. Evidence: TAS. Frequency: Occasional (HP:0040283). (ORPHA:140952)
- Pulmonary artery stenosis (HP:0004415): An abnormal narrowing or constriction of the pulmonary artery, in the main pulmonary artery and/or in the left or right pulmonary artery branches. Evidence: TAS. Frequency: Occasional (HP:0040283). (ORPHA:140952)
- Macular dystrophy (HP:0007754): Macular dystrophy is a nonspecific term for retinal degeneration, generally confined to the macula, usually presumed of genetic origin. Evidence: TAS. Frequency: Occasional (HP:0040283). (ORPHA:140952)
- Mitral atresia (HP:0011560): A congenital defect with failure to open of the mitral valve orifice. Evidence: TAS. Frequency: Occasional (HP:0040283). (ORPHA:140952)
These phenotypes are associated with the disease Syndactyly-telecanthus-anogenital and renal malformations syndrome (ORPHA:140952).